- Babinski sign (HP:0003487): Upturning of the big toe (and sometimes fanning of the other toes) in response to stimulation of the sole of the foot. If the Babinski sign is present it can indicate damage to the corticospinal tract. Evidence: TAS. Frequency: Frequent (HP:0040282). (ORPHA:276244)
- Facial-lingual fasciculations (HP:0007089): Fasciculations affecting the tongue muscle and the musculature of the face. Evidence: TAS. Frequency: Frequent (HP:0040282). (ORPHA:276244)
- Progressive gait ataxia (HP:0007240): A type of gait ataxia displaying progression of clinical severity. Evidence: TAS. Frequency: Frequent (HP:0040282). (ORPHA:276244)
- Abnormal pyramidal sign (HP:0007256): Functional neurological abnormalities related to dysfunction of the pyramidal tract. Evidence: TAS. Frequency: Frequent (HP:0040282). (ORPHA:276244)
- Substantia nigra gliosis (HP:0011960): Focal proliferation of glial cells in the substantia nigra. Evidence: TAS. Frequency: Frequent (HP:0040282). (ORPHA:276244)
- Degeneration of the striatum (HP:0040140). Evidence: TAS. Frequency: Frequent (HP:0040282). (ORPHA:276244)
- Neurogenic bladder (HP:0000011): A type of bladder dysfunction caused by neurologic damage. Neurogenic bladder can be flaccid or spastic. Common manifestatios of neurogenic bladder are overflow incontinence, frequency, urgency, urge incontinence, and retention. Evidence: TAS. Frequency: Occasional (HP:0040283). (ORPHA:276244)
- Vocal cord paralysis (HP:0001605): A loss of the ability to move the vocal folds. Evidence: TAS. Frequency: Occasional (HP:0040283). (ORPHA:276244)
- Abnormal vestibular function (HP:0001751): An abnormality of the functioning of the vestibular apparatus. Evidence: TAS. Frequency: Occasional (HP:0040283). (ORPHA:276244)
- Dysphagia (HP:0002015): Difficulty in swallowing. Evidence: TAS. Frequency: Occasional (HP:0040283). (ORPHA:276244)
- Memory impairment (HP:0002354): An impairment of memory as manifested by a reduced ability to remember things such as dates and names, and increased forgetfulness. Evidence: TAS. Frequency: Occasional (HP:0040283). (ORPHA:276244)
- Sleep disturbance (HP:0002360): An abnormal pattern in the quality, quantity, or characteristics of sleep. Evidence: TAS. Frequency: Occasional (HP:0040283). (ORPHA:276244)
- Muscle spasm (HP:0003394): Sudden and involuntary contractions of one or more muscles. Evidence: TAS. Frequency: Occasional (HP:0040283). (ORPHA:276244)
- Peripheral axonal neuropathy (HP:0003477): An abnormality characterized by disruption of the normal functioning of peripheral axons. Evidence: TAS. Frequency: Occasional (HP:0040283). (ORPHA:276244)
- Abnormality of temperature regulation (HP:0004370): An abnormality of temperature homeostasis. Evidence: TAS. Frequency: Occasional (HP:0040283). (ORPHA:276244)
- Progressive external ophthalmoplegia (HP:0000590): Initial bilateral ptosis followed by limitation of eye movements in all directions and slowing of saccades. Evidence: TAS. Frequency: Very frequent (HP:0040281). (ORPHA:276244)
- Abnormality of extrapyramidal motor function (HP:0002071): A neurological condition related to lesions of the basal ganglia leading to typical abnormalities including akinesia (inability to initiate changes in activity and perform volitional movements rapidly and easily), muscular rigidity (continuous contraction of muscles with constant resistance to passive movement), chorea (widespread arrhythmic movements of a forcible, rapid, jerky, and restless nature), athetosis (inability to sustain the muscles of the fingers, toes, or other group of muscles in a fixed position), and akathisia (inability to remain motionless). Evidence: TAS. Frequency: Very frequent (HP:0040281). (ORPHA:276244)
- Progressive cerebellar ataxia (HP:0002073). Evidence: TAS. Frequency: Very frequent (HP:0040281). (ORPHA:276244)
- Distal lower limb amyotrophy (HP:0008944): Muscular atrophy of distal leg muscles. Evidence: TAS. Frequency: Very frequent (HP:0040281). (ORPHA:276244)
- Proptosis (HP:0000520): An eye that is protruding anterior to the plane of the face to a greater extent than is typical. Evidence: TAS. Frequency: Frequent (HP:0040282). (ORPHA:276244)
- Supranuclear ophthalmoplegia (HP:0000623): A vertical gaze palsy with inability to direct the gaze of the eyes downwards. Evidence: TAS. Frequency: Frequent (HP:0040282). (ORPHA:276244)
- Gaze-evoked nystagmus (HP:0000640): Nystagmus made apparent by looking to the right or to the left. Evidence: TAS. Frequency: Frequent (HP:0040282). (ORPHA:276244)
- Diplopia (HP:0000651): Diplopia is a condition in which a single object is perceived as two images, it is also known as double vision. Evidence: TAS. Frequency: Frequent (HP:0040282). (ORPHA:276244)
- Delayed speech and language development (HP:0000750): A degree of language development that is significantly below the norm for a child of a specified age. Evidence: TAS. Frequency: Frequent (HP:0040282). (ORPHA:276244)
- Spasticity (HP:0001257): A motor disorder characterized by a velocity-dependent increase in tonic stretch reflexes with increased muscle tone, exaggerated (hyperexcitable) tendon reflexes. Evidence: TAS. Frequency: Frequent (HP:0040282). (ORPHA:276244)
- Dysarthria (HP:0001260): Dysarthric speech is a general description referring to a neurological speech disorder characterized by poor articulation. Depending on the involved neurological structures, dysarthria may be further classified as spastic, flaccid, ataxic, hyperkinetic and hypokinetic, or mixed. Evidence: TAS. Frequency: Frequent (HP:0040282). (ORPHA:276244)
- Cerebellar atrophy (HP:0001272): Cerebellar atrophy is defined as a cerebellum with initially normal structures, in a posterior fossa with normal size, which displays enlarged fissures (interfolial spaces) in comparison to the foliae secondary to loss of tissue. Cerebellar atrophy implies irreversible loss of tissue and result from an ongoing progressive disease until a final stage is reached or a single injury, e.g. an intoxication or infectious event. Evidence: TAS. Frequency: Frequent (HP:0040282). (ORPHA:276244)
- Dystonia (HP:0001332): An abnormally increased muscular tone that causes fixed abnormal postures. There is a slow, intermittent twisting motion that leads to exaggerated turning and posture of the extremities and trunk. Evidence: TAS. Frequency: Frequent (HP:0040282). (ORPHA:276244)
- Hyperreflexia (HP:0001347): Hyperreflexia is the presence of hyperactive stretch reflexes of the muscles. Evidence: TAS. Frequency: Frequent (HP:0040282). (ORPHA:276244)
- Dilated fourth ventricle (HP:0002198): An abnormal dilatation of the fourth cerebral ventricle. Evidence: TAS. Frequency: Frequent (HP:0040282). (ORPHA:276244)
- Clumsiness (HP:0002312): Lack of physical coordination resulting in an abnormal tendency to drop items or bump into objects. Evidence: TAS. Frequency: Frequent (HP:0040282). (ORPHA:276244)
- Abnormal lower motor neuron morphology (HP:0002366): Any structural anomaly of the lower motor neuron. Evidence: TAS. Frequency: Frequent (HP:0040282). (ORPHA:276244)
- Degeneration of anterior horn cells (HP:0002398). Evidence: TAS. Frequency: Frequent (HP:0040282). (ORPHA:276244)
- Distal muscle weakness (HP:0002460): Reduced strength of the musculature of the distal extremities. Evidence: TAS. Frequency: Frequent (HP:0040282). (ORPHA:276244)
- Upper motor neuron dysfunction (HP:0002493): A functional anomaly of the upper motor neuron. The upper motor neurons are neurons of the primary motor cortex which project to the brainstem and spinal chord via the corticonuclear, corticobulbar and corticospinal (pyramidal) tracts. They are involved in control of voluntary movements. Dysfunction leads to weakness, impairment of fine motor movements, spasticity, hyperreflexia and abnormal pyramidal signs. Evidence: TAS. Frequency: Frequent (HP:0040282). (ORPHA:276244)
- Spinocerebellar tract degeneration (HP:0002503). Evidence: TAS. Frequency: Frequent (HP:0040282). (ORPHA:276244)
- Skeletal muscle atrophy (HP:0003202): The presence of skeletal muscular atrophy (which is also known as amyotrophy). Evidence: TAS. Frequency: Frequent (HP:0040282). (ORPHA:276244)
- EMG abnormality (HP:0003457): Abnormal results of investigations using electromyography (EMG). Evidence: TAS. Frequency: Frequent (HP:0040282). (ORPHA:276244)
These phenotypes are associated with the disease Machado-Joseph disease type 3 (ORPHA:276244).